- Long philtrum (HP:0000343): Distance between nasal base and midline upper lip vermilion border more than 2 SD above the mean. Alternatively, an apparently increased distance between nasal base and midline upper lip vermilion border. Evidence: TAS. Frequency: Very frequent (HP:0040281). (ORPHA:50810)
- Short neck (HP:0000470): Diminished length of the neck. Evidence: TAS. Frequency: Very frequent (HP:0040281). (ORPHA:50810)
- Hypoparathyroidism (HP:0000829): A condition caused by a deficiency of parathyroid hormone characterized by hypocalcemia and hyperphosphatemia. Evidence: TAS. Frequency: Frequent (HP:0040282). (ORPHA:50810)
- 11 pairs of ribs (HP:0000878): Presence of only 11 pairs of ribs. Evidence: TAS. Frequency: Very frequent (HP:0040281). (ORPHA:50810)
- Adducted thumb (HP:0001181): In the resting position, the tip of the thumb is on, or near, the palm, close to the base of the fourth or fifth finger. Evidence: TAS. Frequency: Very frequent (HP:0040281). (ORPHA:50810)
- Seizure (HP:0001250): A seizure is an intermittent abnormality of nervous system physiology characterized by a transient occurrence of signs and/or symptoms due to abnormal excessive or synchronous neuronal activity in the brain. Evidence: TAS. Frequency: Very frequent (HP:0040281). (ORPHA:50810)
- Hypotonia (HP:0001252): Hypotonia is an abnormally low muscle tone (the amount of tension or resistance to movement in a muscle). Even when relaxed, muscles have a continuous and passive partial contraction which provides some resistance to passive stretching. Hypotonia thus manifests as diminished resistance to passive stretching. Hypotonia is not the same as muscle weakness, although the two conditions can co-exist. Evidence: TAS. Frequency: Frequent (HP:0040282). (ORPHA:50810)
- Global developmental delay (HP:0001263): A delay in the achievement of motor or mental milestones in the domains of development of a child, including motor skills, speech and language, cognitive skills, and social and emotional skills. This term should only be used to describe children younger than five years of age. Evidence: TAS. Frequency: Very frequent (HP:0040281). (ORPHA:50810)
- Hypertonia (HP:0001276): A condition in which there is increased muscle tone so that arms or legs, for example, are stiff and difficult to move. Evidence: TAS. Frequency: Frequent (HP:0040282). (ORPHA:50810)
- Areflexia (HP:0001284): Absence of neurologic reflexes such as the knee-jerk reaction. Evidence: TAS. Frequency: Very frequent (HP:0040281). (ORPHA:50810)
- Cerebellar hypoplasia (HP:0001321): Cerebellar hypoplasia is a descriptive term implying a cerebellum with a reduced volume, but a normal shape and is stable over time. Evidence: TAS. Frequency: Very frequent (HP:0040281). (ORPHA:50810)
- Lissencephaly (HP:0001339): A spectrum of malformations of cortical development caused by insufficient neuronal migration that subsumes the terms agyria, pachygyria and subcortical band heterotopia. See also neuropathological definitions for 2-, 3-, and 4-layered lissencephaly. Evidence: TAS. Frequency: Very frequent (HP:0040281). (ORPHA:50810)
- Failure to thrive (HP:0001508): Failure to thrive (FTT) refers to a child whose physical growth is substantially below the norm. Evidence: TAS. Frequency: Very frequent (HP:0040281). (ORPHA:50810)
- Polyhydramnios (HP:0001561): The presence of excess amniotic fluid in the uterus during pregnancy. Evidence: TAS. Frequency: Very frequent (HP:0040281). (ORPHA:50810)
- Respiratory distress (HP:0002098): Respiratory distress is objectively observable as the physical or emotional consequences from the experience of dyspnea. The physical presentation of respiratory distress is generally referred to as labored breathing, while the sensation of respiratory distress is called shortness of breath or dyspnea. Evidence: TAS. Frequency: Very frequent (HP:0040281). (ORPHA:50810)
- EEG abnormality (HP:0002353): Abnormality observed by electroencephalogram (EEG), which is used to record of the brain's spontaneous electrical activity from multiple electrodes placed on the scalp. Evidence: TAS. Frequency: Very frequent (HP:0040281). (ORPHA:50810)
- Micromelia (HP:0002983): The presence of abnormally small extremities. Evidence: TAS. Frequency: Very frequent (HP:0040281). (ORPHA:50810)
- Short nose (HP:0003196): Distance from nasion to subnasale more than two standard deviations below the mean, or alternatively, an apparently decreased length from the nasal root to the nasal tip. Evidence: TAS. Frequency: Very frequent (HP:0040281). (ORPHA:50810)
- Generalized hypertrichosis (HP:0004554): Generalized excessive, abnormal hairiness. Evidence: TAS. Frequency: Very frequent (HP:0040281). (ORPHA:50810)
- Secondary microcephaly (HP:0005484): Head circumference which falls below 2 standard deviations below the mean for age and gender because of insufficient head growth after birth. Evidence: TAS. Frequency: Very frequent (HP:0040281). (ORPHA:50810)
- Bilateral single transverse palmar creases (HP:0007598): The distal and proximal transverse palmar creases are merged into a single transverse palmar crease on both hands. Evidence: TAS. Frequency: Very frequent (HP:0040281). (ORPHA:50810)
- Fetal pyelectasis (HP:0010945): Mild pyelectasis is defined as a hypoechoic spherical or elliptical space within the renal pelvis that measures at least 5mm and not more than 10 mm. The measurement is taken on a transverse section through the fetal renal pelvis using the maximum anterior-to-posterior measurement. Evidence: TAS. Frequency: Very frequent (HP:0040281). (ORPHA:50810)
- Abnormal circulating calcium-phosphate regulating hormone concentration (HP:0100530): Any deviation from the normal concentration in the blood circulation of a hormone that is involved in the regulation of phosphate and calcium. Evidence: TAS. Frequency: Frequent (HP:0040282). (ORPHA:50810)
- Palpebral edema (HP:0100540): Edema in the region of the eyelids. Evidence: TAS. Frequency: Very frequent (HP:0040281). (ORPHA:50810)
- Coarse facial features (HP:0000280): Absence of fine and sharp appearance of brows, nose, lips, mouth, and chin, usually because of rounded and heavy features or thickened skin with or without thickening of subcutaneous and bony tissues. Evidence: TAS. Frequency: Very frequent (HP:0040281). (ORPHA:50810)
These phenotypes are associated with the disease Microlissencephaly-micromelia syndrome (ORPHA:50810).